Phenotypes associated with the disease Amelogenesis imperfecta (ORPHA:88661):
- Yellow-brown discoloration of the teeth (HP:0006286). Evidence: TAS. Frequency: Very frequent (HP:0040281). (ORPHA:88661)
- Abnormality of dental color (HP:0011073): A developmental defect of tooth color. Evidence: TAS. Frequency: Very frequent (HP:0040281). (ORPHA:88661)
- Impaired mastication (HP:0005216): An abnormal reduction in the ability to masticate (chew), i.e., in the ability to crush and ground food in preparation for swallowing. Evidence: TAS. Frequency: Frequent (HP:0040282). (ORPHA:88661)
- Enamel hypomineralization (HP:0006285): A decreased amount of enamel mineralization. Hypomineralized enamel has a brown discoloration and brittle aspect. Evidence: TAS. Frequency: Frequent (HP:0040282). (ORPHA:88661)
- Enamel hypoplasia (HP:0006297): Developmental hypoplasia of the dental enamel. Evidence: TAS. Frequency: Frequent (HP:0040282). (ORPHA:88661)
- Anterior open-bite malocclusion (HP:0009102): Anterior open bite is a malocclusion characterized by a gap between the anterior teeth (incisors), that is, by a deficiency in the normal vertical overlap between antagonist incisal edges when the posterior teeth are in occlusion. Evidence: TAS. Frequency: Frequent (HP:0040282). (ORPHA:88661)
- Hypocalcification of dental enamel (HP:0011084): A form of hypomineralization of enamel characterized by reduced calcification. Evidence: TAS. Frequency: Frequent (HP:0040282). (ORPHA:88661)
- Hypomature dental enamel (HP:0011085): A form of hypomineralization of enamel characterized by a chalky appearance of the enamel with orange, brown, or white color. Evidence: TAS. Frequency: Frequent (HP:0040282). (ORPHA:88661)
- Fragile teeth (HP:0025124): A tendency of teeth to fracture as manifested by a history of repeated fracture of the dental enamel without adequate trauma. Evidence: TAS. Frequency: Frequent (HP:0040282). (ORPHA:88661)
- Taurodontia (HP:0000679): Increased volume of dental pulp of permanent molar characterized by a crown body-root ratio equal or larger than 1:1 or an elongated pulp chambers and apical displacement of the bifurcation or trifurcation of the roots. Evidence: TAS. Frequency: Occasional (HP:0040283). (ORPHA:88661)
- Hypoplasia of teeth (HP:0000685): Developmental hypoplasia of teeth. Evidence: TAS. Frequency: Occasional (HP:0040283). (ORPHA:88661)
- Widely spaced teeth (HP:0000687): Increased spaces (diastemata) between most of the teeth in the same dental arch. Evidence: TAS. Frequency: Occasional (HP:0040283). (ORPHA:88661)
- Multiple unerupted teeth (HP:0006283): The presence of multiple embedded tooth germs which have failed to erupt. Evidence: TAS. Frequency: Occasional (HP:0040283). (ORPHA:88661)
- Abnormal dentin morphology (HP:0010299): Any abnormality of dentin. Evidence: TAS. Frequency: Occasional (HP:0040283). (ORPHA:88661)
- Abnormal permanent molar morphology (HP:0011071): An abnormality of morphology of permanent molar. Evidence: TAS. Frequency: Occasional (HP:0040283). (ORPHA:88661)
- Abnormal jaw morphology (HP:0030791): A structural anomaly of the jaw, the bony structure of the mouth that consists of the mandible and the maxilla. Evidence: TAS. Frequency: Occasional (HP:0040283). (ORPHA:88661)